Phenotypes associated with the disease Loose anagen syndrome (ORPHA:168):
- Iris coloboma (HP:0000612): A coloboma of the iris. Evidence: TAS. Frequency: Frequent (HP:0040282). (ORPHA:168)
- Abnormal hair morphology (HP:0001595): An abnormality of the hair. Evidence: TAS. Frequency: Very frequent (HP:0040281). (ORPHA:168)
- Abnormal hair whorl (HP:0010721): An abnormal hair whorl (that is, a patch of hair growing in the opposite direction of the rest of the hair). Evidence: TAS. Frequency: Very frequent (HP:0040281). (ORPHA:168)